Phenotypes associated with the disease urinary bladder cancer (OMIM:109800, an entry in Online Mendelian Inheritance in Man):
- Typified by somatic mosaicism (HP:0001442, a Human Phenotype Ontology term): Description of conditions in which affected individuals typically display somatic mosaicism, i.e., genetically distinct populations of somatic cells in a given organism caused by DNA mutations, epigenetic alterations of DNA, chromosomal abnormalities or the spontaneous reversion of inherited mutations. In many conditions typified by somatic mosaicism, constitutive mutation is lethal and cases are exclusively or predominantly mosaic. Evidence: IEA. (OMIM:109800)
- Transitional cell carcinoma of the bladder (HP:0006740, a Human Phenotype Ontology term): The presence of a carcinoma of the urinary bladder with origin in a transitional epithelial cell. Evidence: IEA. (OMIM:109800)
- Autosomal dominant inheritance (HP:0000006, a Human Phenotype Ontology term): A mode of inheritance that is observed for traits related to a gene encoded on one of the autosomes (i.e., the human chromosomes 1-22) in which a trait manifests in heterozygotes. In the context of medical genetics, an autosomal dominant disorder is caused when a single copy of the mutant allele is present. Males and females are affected equally, and can both transmit the disorder with a risk of 50% for each child of inheriting the mutant allele. Evidence: IEA. (OMIM:109800)
- Bladder neoplasm (HP:0009725, a Human Phenotype Ontology term): The presence of a neoplasm of the urinary bladder. Evidence: TAS. (OMIM:109800)